- Atypical behavior (HP:0000708): Atypical behavior is an abnormality in a person's actions that can be controlled or modulated by the will of the individual. While abnormal behaviors can be difficult to control, they are distinct from other abnormal actions that cannot be affected by the individual's will. Evidence: PCS. (PMID:25644381)
- Absent speech (HP:0001344): Complete lack of development of speech and language abilities. Evidence: PCS. (PMID:25644381)
- X-linked recessive inheritance (HP:0001419): A mode of inheritance that is observed for recessive traits related to a gene encoded on the X chromosome. In the context of medical genetics, X-linked recessive disorders manifest in males (who have one copy of the X chromosome and are thus hemizygotes), but generally not in female heterozygotes who have one mutant and one normal allele. Evidence: PCS. (PMID:25644381)
- Intellectual disability (HP:0001249): The term intellectual disability or intellectual developmental disorder is used to describe significantly sub-average intellectual and adaptive functioning based on clinical assessment and as measured by individually administered, appropriately normed, standardized and validated tests of intellectual functioning and adaptive behavior, with onset during the developmental period from infancy through adolescence. Evidence: PCS. (PMID:25644381)
These phenotypes are associated with the disease intellectual disability, X-linked 105 (OMIM:300984).